Phenotypes associated with the disease autosomal recessive nonsyndromic hearing loss 14 (OMIM:603678):
- Sensorineural hearing impairment (HP:0000407): A type of hearing impairment in one or both ears related to an abnormal functionality of the cochlear nerve. Evidence: PCS. Onset: Infantile onset (HP:0003593). (PMID:9887371)
- Autosomal recessive inheritance (HP:0000007): A mode of inheritance that is observed for traits related to a gene encoded on one of the autosomes (i.e., the human chromosomes 1-22) in which a trait manifests in individuals with two pathogenic alleles, either homozygotes (two copies of the same mutant allele) or compound heterozygotes (whereby each copy of a gene has a distinct mutant allele). Evidence: TAS. (OMIM:603678)